Phenotypes associated with the disease FETAL HEMOGLOBIN QUANTITATIVE TRAIT LOCUS 3 (OMIM:305435):
- Abnormality of blood and blood-forming tissues (HP:0001871): An abnormality of the hematopoietic system. Evidence: IEA. (OMIM:305435)
- X-linked inheritance (HP:0001417): A mode of inheritance that is observed for traits related to a gene encoded on the X chromosome. Evidence: IEA. (OMIM:305435)